Phenotypes associated with the disease urticaria, familial localized heat (OMIM:191950):
- Urticaria (HP:0001025): Raised, well-circumscribed areas of erythema and edema involving the dermis and epidermis. Urticaria is intensely pruritic, and blanches completely with pressure. Evidence: IEA. (OMIM:191950)
- Autosomal dominant inheritance (HP:0000006): A mode of inheritance that is observed for traits related to a gene encoded on one of the autosomes (i.e., the human chromosomes 1-22) in which a trait manifests in heterozygotes. In the context of medical genetics, an autosomal dominant disorder is caused when a single copy of the mutant allele is present. Males and females are affected equally, and can both transmit the disorder with a risk of 50% for each child of inheriting the mutant allele. Evidence: IEA. (OMIM:191950)